- Sensorineural hearing impairment (HP:0000407): A type of hearing impairment in one or both ears related to an abnormal functionality of the cochlear nerve. Evidence: TAS. Frequency: Very frequent (HP:0040281). (ORPHA:2202)
- Hyperkeratosis (HP:0000962): Hyperkeratosis is a histopathological term defining a thickened stratum corneum and may be present in many different skin conditions, with many possible overlaps. Hyperkeratosis refers to the increased thickness of the stratum corneum, the outer layer of the skin. Hyperkeratosis is subclassified as orthokeratotic or parakeratotic. Orthokeratotic hyperkeratosis refers to the thickening of the keratin layer with preserved keratinocyte maturation, while parakeratotic hyperkeratosis shows retained nuclei as a sign of delayed maturation of keratinocytes. Evidence: TAS. Frequency: Very frequent (HP:0040281). (ORPHA:2202)
- Palmoplantar keratoderma (HP:0000982): Abnormal thickening of the skin of the palms of the hands and the soles of the feet. Evidence: TAS. Frequency: Very frequent (HP:0040281). (ORPHA:2202)
These phenotypes are associated with the disease Palmoplantar keratoderma-deafness syndrome (ORPHA:2202).